Phenotypes associated with the disease 20q13.33 microdeletion syndrome (ORPHA:261311):
- Delayed speech and language development (HP:0000750): A degree of language development that is significantly below the norm for a child of a specified age. Evidence: TAS. Frequency: Very frequent (HP:0040281). (ORPHA:261311)
- Intellectual disability (HP:0001249): The term intellectual disability or intellectual developmental disorder is used to describe significantly sub-average intellectual and adaptive functioning based on clinical assessment and as measured by individually administered, appropriately normed, standardized and validated tests of intellectual functioning and adaptive behavior, with onset during the developmental period from infancy through adolescence. Evidence: TAS. Frequency: Very frequent (HP:0040281). (ORPHA:261311)
- Hypotonia (HP:0001252): Hypotonia is an abnormally low muscle tone (the amount of tension or resistance to movement in a muscle). Even when relaxed, muscles have a continuous and passive partial contraction which provides some resistance to passive stretching. Hypotonia thus manifests as diminished resistance to passive stretching. Hypotonia is not the same as muscle weakness, although the two conditions can co-exist. Evidence: TAS. Frequency: Very frequent (HP:0040281). (ORPHA:261311)
- Growth delay (HP:0001510): A deficiency or slowing down of growth pre- and postnatally. Evidence: TAS. Frequency: Very frequent (HP:0040281). (ORPHA:261311)
- Small for gestational age (HP:0001518): Smaller than normal size according to sex and gestational age related norms, defined as a weight below the 10th percentile for the gestational age. Evidence: TAS. Frequency: Very frequent (HP:0040281). (ORPHA:261311)
- Abnormal limb bone morphology (HP:0002813): Any abnormality of bones of the arms or legs. Evidence: TAS. Frequency: Very frequent (HP:0040281). (ORPHA:261311)
- Dilation of Virchow-Robin spaces (HP:0012520): Increased dimensions of the Virchow-Robin spaces (also known as perivascular spaces), which surround the walls of vessels as they course from the subarachnoid space through the brain parenchyma. Perivascular spaces are commonly microscopic, and not visible on conventional neuroimaging. This term refers to an increase of size of these spaces such that they are visible on neuroimaging (usually magnetic resonance imaging). The dilatations are regular cavities that always contain a patent artery. Evidence: TAS. Frequency: Very frequent (HP:0040281). (ORPHA:261311)
- Neurodevelopmental delay (HP:0012758): Neurodevelopmental delay (NDD) refers to delays in the maturation of the brain and central nervous system; infants and young children with NDD may experience delays in the development of one or more skills including gross motor abilities, fine-motor coordination, language abilities and ability to solve increasingly complex problems. Evidence: TAS. Frequency: Very frequent (HP:0040281). (ORPHA:261311)
- Posteriorly rotated ears (HP:0000358): A type of abnormal location of the ears in which the position of the ears is characterized by posterior rotation (the superior part of the ears is rotated towards the back of the head, and the inferior part of the ears towards the front). Evidence: TAS. Frequency: Frequent (HP:0040282). (ORPHA:261311)
- Downslanted palpebral fissures (HP:0000494): The palpebral fissure inclination is more than two standard deviations below the mean. Evidence: TAS. Frequency: Frequent (HP:0040282). (ORPHA:261311)
- Upslanted palpebral fissure (HP:0000582): The palpebral fissure inclination is more than two standard deviations above the mean for age (objective); or, the inclination of the palpebral fissure is greater than typical for age. Evidence: TAS. Frequency: Frequent (HP:0040282). (ORPHA:261311)
- Seizure (HP:0001250): A seizure is an intermittent abnormality of nervous system physiology characterized by a transient occurrence of signs and/or symptoms due to abnormal excessive or synchronous neuronal activity in the brain. Evidence: TAS. Frequency: Frequent (HP:0040282). (ORPHA:261311)
- Failure to thrive in infancy (HP:0001531). Evidence: TAS. Frequency: Frequent (HP:0040282). (ORPHA:261311)
- Short lower limbs (HP:0006385): Shortening of the legs related to developmental hypoplasia of the bones of the leg. Evidence: TAS. Frequency: Frequent (HP:0040282). (ORPHA:261311)
- Hypospadias (HP:0000047): Abnormal position of urethral meatus on the ventral penile shaft (underside) characterized by displacement of the urethral meatus from the tip of the glans penis to the ventral surface of the penis, scrotum, or perineum. Evidence: TAS. Frequency: Occasional (HP:0040283). (ORPHA:261311)
- Thin vermilion border (HP:0000233): Height of the vermilion of the medial part of the lip more than 2 SD below the mean, or apparently reduced height of the vermilion of the lip in the frontal view. The vermilion is the red part of the lips (and confusingly, the vermilion itself is also often referred to as being equivalent the lips). Evidence: TAS. Frequency: Occasional (HP:0040283). (ORPHA:261311)
- Epicanthus (HP:0000286): A fold of skin starting above the medial aspect of the upper eyelid and arching downward to cover, pass in front of and lateral to the medial canthus. Evidence: TAS. Frequency: Occasional (HP:0040283). (ORPHA:261311)
- Facial hypotonia (HP:0000297): Reduced muscle tone of a muscle that is innervated by the facial nerve (the seventh cranial nerve). Evidence: TAS. Frequency: Occasional (HP:0040283). (ORPHA:261311)
- Hypertelorism (HP:0000316): Interpupillary distance more than 2 SD above the mean (alternatively, the appearance of an increased interpupillary distance or widely spaced eyes). Evidence: TAS. Frequency: Occasional (HP:0040283). (ORPHA:261311)
- Smooth philtrum (HP:0000319): Flat skin surface, with no ridge formation in the central region of the upper lip between the nasal base and upper vermilion border. Evidence: TAS. Frequency: Occasional (HP:0040283). (ORPHA:261311)
- Triangular face (HP:0000325): Facial contour, as viewed from the front, triangular in shape, with breadth at the temples and tapering to a narrow chin. Evidence: TAS. Frequency: Occasional (HP:0040283). (ORPHA:261311)
- Narrow forehead (HP:0000341): Width of the forehead or distance between the frontotemporales is more than two standard deviations below the mean (objective); or apparently narrow intertemporal region (subjective). Evidence: TAS. Frequency: Occasional (HP:0040283). (ORPHA:261311)
- Bulbous nose (HP:0000414): Increased volume and globular shape of the anteroinferior aspect of the nose. Evidence: TAS. Frequency: Occasional (HP:0040283). (ORPHA:261311)
- Narrow nose (HP:0000460): Interalar distance more than 2 SD below the mean for age, or alternatively, an apparently decreased width of the nasal base and alae. Evidence: TAS. Frequency: Occasional (HP:0040283). (ORPHA:261311)
- Proptosis (HP:0000520): An eye that is protruding anterior to the plane of the face to a greater extent than is typical. Evidence: TAS. Frequency: Occasional (HP:0040283). (ORPHA:261311)
- Autistic behavior (HP:0000729): Persistent deficits in social interaction and communication and interaction as well as a markedly restricted repertoire of activity and interest as well as repetitive patterns of behavior. Evidence: TAS. Frequency: Occasional (HP:0040283). (ORPHA:261311)
- Sacral dimple (HP:0000960): A cutaneous indentation resulting from tethering of the skin to underlying structures (bone) of the intergluteal cleft. Evidence: TAS. Frequency: Occasional (HP:0040283). (ORPHA:261311)
- Tapered finger (HP:0001182): The gradual reduction in girth of the finger from proximal to distal. Evidence: TAS. Frequency: Occasional (HP:0040283). (ORPHA:261311)
- Oligohydramnios (HP:0001562): Diminished amniotic fluid volume in pregnancy. Evidence: TAS. Frequency: Occasional (HP:0040283). (ORPHA:261311)
- Atrial septal defect (HP:0001631): Atrial septal defect (ASD) is a congenital abnormality of the interatrial septum that enables blood flow between the left and right atria via the interatrial septum. Evidence: TAS. Frequency: Occasional (HP:0040283). (ORPHA:261311)
- Abnormal cardiac ventricle morphology (HP:0001713): An abnormality of a cardiac ventricle. Evidence: TAS. Frequency: Occasional (HP:0040283). (ORPHA:261311)
- Talipes equinovarus (HP:0001762): Talipes equinovarus (also called clubfoot) typically has four main components: inversion and adduction of the forefoot; inversion of the heel and hindfoot; equinus (limitation of extension) of the ankle and subtalar joint; and internal rotation of the leg. Evidence: TAS. Frequency: Occasional (HP:0040283). (ORPHA:261311)
- Pes planus (HP:0001763): A foot where the longitudinal arch of the foot is in contact with the ground or floor when the individual is standing; or, in a patient lying supine, a foot where the arch is in contact with the surface of a flat board pressed against the sole of the foot by the examiner with a pressure similar to that expected from weight bearing; or, the height of the arch is reduced. Evidence: TAS. Frequency: Occasional (HP:0040283). (ORPHA:261311)
- Hallux valgus (HP:0001822): Lateral deviation of the great toe (i.e., in the direction of the little toe). Evidence: TAS. Frequency: Occasional (HP:0040283). (ORPHA:261311)
- Hypoplasia of the corpus callosum (HP:0002079): Underdevelopment of the corpus callosum. Evidence: TAS. Frequency: Occasional (HP:0040283). (ORPHA:261311)
- Delayed CNS myelination (HP:0002188): Delayed myelination in the central nervous system. Evidence: TAS. Frequency: Occasional (HP:0040283). (ORPHA:261311)
- Highly arched eyebrow (HP:0002553): Increased height of the central portion of the eyebrow, forming a crescent, semicircular, or inverted U shape. Evidence: TAS. Frequency: Occasional (HP:0040283). (ORPHA:261311)
- Hematochezia (HP:0002573): The passage of fresh (red) blood per anus, usually in or with stools. Most rectal bleeding comes from the colon, rectum, or anus. Evidence: TAS. Frequency: Occasional (HP:0040283). (ORPHA:261311)
- Hip dislocation (HP:0002827): Displacement of the femur from its normal location in the hip joint. Evidence: TAS. Frequency: Occasional (HP:0040283). (ORPHA:261311)
- Aplasia/Hypoplasia of the nipples (HP:0006709). Evidence: TAS. Frequency: Occasional (HP:0040283). (ORPHA:261311)
- Prominent crus of helix (HP:0009899): The presence of an abnormally prominent of the crus of the helix. That is, development of the crus helix to the same degree as an average antihelix stem or helix. Evidence: TAS. Frequency: Occasional (HP:0040283). (ORPHA:261311)
- Hypoplastic aortic arch (HP:0012304): Underdevelopment of the arch of aorta. Evidence: TAS. Frequency: Occasional (HP:0040283). (ORPHA:261311)
- Decreased scrotal rugation (HP:0012858): Decreased number or density of the folded ridges (wrinkles) of skin of the scrotum. Evidence: TAS. Frequency: Occasional (HP:0040283). (ORPHA:261311)